Phenotypes associated with the disease Lenz-Majewski hyperostotic dysplasia (ORPHA:2658):
- Joint hypermobility (HP:0001382): The capability that a joint (or a group of joints) has to move, passively and/or actively, beyond normal limits along physiological axes. Evidence: TAS. Frequency: Very frequent (HP:0040281). (ORPHA:2658)
- Large fontanelles (HP:0000239): In newborns, the two frontal bones, two parietal bones, and one occipital bone are joined by fibrous sutures, which form a small posterior fontanelle, and a larger, diamond-shaped anterior fontanelle. These regions allow for the skull to pass the birth canal and for later growth. The fontanelles gradually ossify, whereby the posterior fontanelle usually closes by eight weeks and the anterior fontanelle by the 9th to 16th month of age. Large fontanelles are diagnosed if the fontanelles are larger than age-dependent norms. Evidence: TAS. Frequency: Very frequent (HP:0040281). (ORPHA:2658)
- Macrocephaly (HP:0000256): Occipitofrontal (head) circumference greater than 97th centile compared to appropriate, age matched, sex-matched normal standards. Alternatively, a apparently increased size of the cranium. Evidence: TAS. Frequency: Very frequent (HP:0040281). (ORPHA:2658)
- Delayed cranial suture closure (HP:0000270): Infants normally have two fontanels at birth, the diamond-shaped anterior fontanelle at the junction of the coronal and sagittal sutures, and the posterior fontanelle at the intersection of the occipital and parietal bones. The posterior fontanelle usually closes by the 8th week of life, and the anterior fontanel closes by the 18th month of life on average. This term applies if there is delay of closure of the fontanelles beyond the normal age. Evidence: TAS. Frequency: Very frequent (HP:0040281). (ORPHA:2658)
- Mandibular prognathia (HP:0000303): Abnormal prominence of the chin related to increased length of the mandible. Evidence: TAS. Frequency: Very frequent (HP:0040281). (ORPHA:2658)
- Hypertelorism (HP:0000316): Interpupillary distance more than 2 SD above the mean (alternatively, the appearance of an increased interpupillary distance or widely spaced eyes). Evidence: TAS. Frequency: Very frequent (HP:0040281). (ORPHA:2658)
- Broad forehead (HP:0000337): Width of the forehead or distance between the frontotemporales is more than two standard deviations above the mean (objective); or apparently increased distance between the two sides of the forehead. Evidence: TAS. Frequency: Very frequent (HP:0040281). (ORPHA:2658)
- Macrotia (HP:0000400): Median longitudinal ear length greater than two standard deviations above the mean and median ear width greater than two standard deviations above the mean (objective); or, apparent increase in length and width of the pinna (subjective). Evidence: TAS. Frequency: Very frequent (HP:0040281). (ORPHA:2658)
- Choanal atresia (HP:0000453): Absence or abnormal closure of the choana (the posterior nasal aperture). Most embryologists believe that posterior choanal atresia results from a failure of rupture between the 35th and 38th day of fetal life of the partition which separates the bucconasal or buccopharyngeal membranes. The resultant choanal atresia may be unilateral or bilateral, bony or membranous, complete or incomplete. In over 90 per cent of cases the obstruction is bony, while in the remainder it is membranous. The bony type of atresia is commonly located 1-2 mm. anterior to the posterior edge of the hard palate, and the osseous septum varies in thickness from 1 to 10 mm. In the membranous form of choanal atresia the obstruction usually occurs further posteriorly. In approximately one third of cases the atresia is bilateral. Evidence: TAS. Frequency: Very frequent (HP:0040281). (ORPHA:2658)
- Abnormal dental enamel morphology (HP:0000682): An abnormality of the dental enamel. Evidence: TAS. Frequency: Very frequent (HP:0040281). (ORPHA:2658)
- Abnormal metaphysis morphology (HP:0000944): An abnormality of one or more metaphysis, i.e., of the somewhat wider portion of a long bone that is adjacent to the epiphyseal growth plate and grows during childhood. Evidence: TAS. Frequency: Very frequent (HP:0040281). (ORPHA:2658)
- Brachydactyly (HP:0001156): Digits that appear disproportionately short compared to the hand/foot. The word brachydactyly is used here to describe a series distinct patterns of shortened digits (brachydactyly types A-E). This is the sense used here. Evidence: TAS. Frequency: Very frequent (HP:0040281). (ORPHA:2658)
- Intellectual disability (HP:0001249): The term intellectual disability or intellectual developmental disorder is used to describe significantly sub-average intellectual and adaptive functioning based on clinical assessment and as measured by individually administered, appropriately normed, standardized and validated tests of intellectual functioning and adaptive behavior, with onset during the developmental period from infancy through adolescence. Evidence: TAS. Frequency: Very frequent (HP:0040281). (ORPHA:2658)
- Global developmental delay (HP:0001263): A delay in the achievement of motor or mental milestones in the domains of development of a child, including motor skills, speech and language, cognitive skills, and social and emotional skills. This term should only be used to describe children younger than five years of age. Evidence: TAS. Frequency: Very frequent (HP:0040281). (ORPHA:2658)
- Specific learning disability (HP:0001328): Impairment of certain skills such as reading or writing, coordination, self-control, or attention that interfere with the ability to learn. The impairment is not related to a global deficiency of intelligence. Evidence: TAS. Frequency: Very frequent (HP:0040281). (ORPHA:2658)
- Redundant skin (HP:0001582): Loose and sagging skin often associated with loss of skin elasticity. Evidence: TAS. Frequency: Very frequent (HP:0040281). (ORPHA:2658)
- Thickened calvaria (HP:0002684): The presence of an abnormally thick calvaria. Evidence: TAS. Frequency: Very frequent (HP:0040281). (ORPHA:2658)
- Delayed skeletal maturation (HP:0002750): A decreased rate of skeletal maturation. Delayed skeletal maturation can be diagnosed on the basis of an estimation of the bone age from radiographs of specific bones in the human body. Evidence: TAS. Frequency: Very frequent (HP:0040281). (ORPHA:2658)
- Abnormal cortical bone morphology (HP:0003103): An abnormality of compact bone (also known as cortical bone), which forms the dense surface of bones. Evidence: TAS. Frequency: Very frequent (HP:0040281). (ORPHA:2658)
- Severe short stature (HP:0003510): A severe degree of short stature, more than -4 SD from the mean corrected for age and sex. Evidence: TAS. Frequency: Very frequent (HP:0040281). (ORPHA:2658)
- Short palm (HP:0004279): Short palm. Evidence: TAS. Frequency: Very frequent (HP:0040281). (ORPHA:2658)
- Cranial hyperostosis (HP:0004437): Excessive growth of the bones of cranium, i.e., of the skull. Evidence: TAS. Frequency: Very frequent (HP:0040281). (ORPHA:2658)
- Facial hyperostosis (HP:0005465): Excessive growth (overgrowth) of the facial bones, that is of the facial skeleton. Evidence: TAS. Frequency: Very frequent (HP:0040281). (ORPHA:2658)
- Finger syndactyly (HP:0006101): Webbing or fusion of the fingers, involving soft parts only or including bone structure. Bony fusions are referred to as "bony" Syndactyly if the fusion occurs in a radio-ulnar axis. Fusions of bones of the fingers in a proximo-distal axis are referred to as "Symphalangism". Evidence: TAS. Frequency: Very frequent (HP:0040281). (ORPHA:2658)
- Aplastic clavicle (HP:0006660): Absence of the clavicles as a developmental defect. Evidence: TAS. Frequency: Very frequent (HP:0040281). (ORPHA:2658)
- Prematurely aged appearance (HP:0007495). Evidence: TAS. Frequency: Very frequent (HP:0040281). (ORPHA:2658)
- Aplasia/Hypoplasia of the skin (HP:0008065). Evidence: TAS. Frequency: Very frequent (HP:0040281). (ORPHA:2658)
- Finger symphalangism (HP:0009700): An abnormal union between bones or parts of bones of the fingers. The synonymous term "symphalangism of the hand" may be translated as fusions of bones of varying digree, that involve at least one phalangeal bone of the hand. If bony fusions are referred to as "Symphalangism" the fusion occurs in a proximo-distal axis. Fusions of bones of the fingers in a radio-ulnar axis are referred to as "bony" Syndactyly. Evidence: TAS. Frequency: Very frequent (HP:0040281). (ORPHA:2658)
- Increased bone mineral density (HP:0011001): An abnormal increase of bone mineral density, that is, of the amount of matter per cubic centimeter of bones which is often referred to as osteosclerosis. Osteosclerosis can be detected on radiological examination as an increased whiteness (density) of affected bones. Evidence: TAS. Frequency: Very frequent (HP:0040281). (ORPHA:2658)
- Osteopetrosis (HP:0011002): Abnormally increased formation of dense trabecular bone tissue. Despite the increased density of bone tissue, osteopetrotic bones tend to be more fracture-prone than normal. Evidence: TAS. Frequency: Very frequent (HP:0040281). (ORPHA:2658)
- Inguinal hernia (HP:0000023): Protrusion of the contents of the abdominal cavity through the inguinal canal. Evidence: TAS. Frequency: Frequent (HP:0040282). (ORPHA:2658)
- Cryptorchidism (HP:0000028): Testis in inguinal canal. That is, absence of one or both testes from the scrotum owing to failure of the testis or testes to descend through the inguinal canal to the scrotum. Evidence: TAS. Frequency: Frequent (HP:0040282). (ORPHA:2658)
- Abnormal penis morphology (HP:0000036): Abnormality of the male external sex organ. Evidence: TAS. Frequency: Frequent (HP:0040282). (ORPHA:2658)
- Epispadias (HP:0000039): Epispadias is a urogenital malformation characterized by the failure of the urethral tube to tubularize on the dorsal aspect. Unlike in hypospadias, where the meatus is on the ventral aspect, children with epispadias have a wide-open urethral plate on the dorsum. It is commonly seen as a component in the spectrum of bladder exstrophy-epispadias-complex. Isolated epispadias constitutes less than 10 percent of the total cases of epispadias. Evidence: TAS. Frequency: Frequent (HP:0040282). (ORPHA:2658)
- Hypospadias (HP:0000047): Abnormal position of urethral meatus on the ventral penile shaft (underside) characterized by displacement of the urethral meatus from the tip of the glans penis to the ventral surface of the penis, scrotum, or perineum. Evidence: TAS. Frequency: Frequent (HP:0040282). (ORPHA:2658)
- Wide mouth (HP:0000154): Distance between the oral commissures more than 2 SD above the mean. Alternatively, an apparently increased width of the oral aperture (subjective). Evidence: TAS. Frequency: Frequent (HP:0040282). (ORPHA:2658)
- Abnormal nasolacrimal system morphology (HP:0000614): An abnormality of the nasolacrimal drainage system, which serves as a conduit for tear flow from the external eye to the nasal cavity. Evidence: TAS. Frequency: Frequent (HP:0040282). (ORPHA:2658)
- Abnormal finger morphology (HP:0001167): An anomaly of a finger. Evidence: TAS. Frequency: Frequent (HP:0040282). (ORPHA:2658)
- Elbow ankylosis (HP:0003070). Evidence: TAS. Frequency: Frequent (HP:0040282). (ORPHA:2658)
- Abnormal metacarpal morphology (HP:0005916): Any abnormal shape or structure of the metacarpal bones. Evidence: TAS. Frequency: Frequent (HP:0040282). (ORPHA:2658)
- Facial palsy (HP:0010628): Facial nerve palsy is a dysfunction of cranial nerve VII (the facial nerve) that results in inability to control facial muscles on the affected side with weakness of the muscles of facial expression and eye closure. This can either be present in unilateral or bilateral form. Evidence: TAS. Frequency: Frequent (HP:0040282). (ORPHA:2658)
- Thick vermilion border (HP:0012471): Increased width of the skin of vermilion border region of upper lip. Evidence: TAS. Frequency: Frequent (HP:0040282). (ORPHA:2658)
- Femoral hernia (HP:0100541): A hernia which occurs just below the inguinal ligament, where abdominal contents pass through a naturally occurring weakness called the femoral canal. Evidence: TAS. Frequency: Frequent (HP:0040282). (ORPHA:2658)
- Hypogonadism (HP:0000135): A decreased functionality of the gonad. Evidence: TAS. Frequency: Occasional (HP:0040283). (ORPHA:2658)
- Cleft palate (HP:0000175): Cleft palate is a developmental defect of the palate resulting from a failure of fusion of the palatine processes and manifesting as a separation of the roof of the mouth (soft and hard palate). Evidence: TAS. Frequency: Occasional (HP:0040283). (ORPHA:2658)
- Submucous cleft hard palate (HP:0000176): Hard-palate submucous clefts are characterized by bony defects in the midline of the bony palate that are covered by the mucous membrane of the roof of the mouth. It may be possible to detect a submucous cleft hard palate upon palpation as a notch in the bony palate. Evidence: TAS. Frequency: Occasional (HP:0040283). (ORPHA:2658)
- Bifid uvula (HP:0000193): Uvula separated into two parts most easily seen at the tip. Evidence: TAS. Frequency: Occasional (HP:0040283). (ORPHA:2658)
- Hydrocephalus (HP:0000238): Hydrocephalus is an active distension of the ventricular system of the brain resulting from inadequate passage of CSF from its point of production within the cerebral ventricles to its point of absorption into the systemic circulation. Evidence: TAS. Frequency: Occasional (HP:0040283). (ORPHA:2658)
- Hypotonia (HP:0001252): Hypotonia is an abnormally low muscle tone (the amount of tension or resistance to movement in a muscle). Even when relaxed, muscles have a continuous and passive partial contraction which provides some resistance to passive stretching. Hypotonia thus manifests as diminished resistance to passive stretching. Hypotonia is not the same as muscle weakness, although the two conditions can co-exist. Evidence: TAS. Frequency: Occasional (HP:0040283). (ORPHA:2658)
- Agenesis of corpus callosum (HP:0001274): Absence of the corpus callosum as a result of the failure of the corpus callosum to develop, which can be the result of a failure in any one of the multiple steps of callosal development including cellular proliferation and migration, axonal growth or glial patterning at the midline. Evidence: TAS. Frequency: Occasional (HP:0040283). (ORPHA:2658)
- Absent septum pellucidum (HP:0001331): Absence of the septum pellucidum (meaning translucent wall in Latin - SP), also known as the ventricle of Sylvius. The septum pellucidum is a thin, triangular double membrane separating the frontal horns of the right and left lateral ventricles of the brain. It extends between the anterior portion of the corpus callosum, and the body of the fornix and its width varies from 1.5 to 3.0 mm. Evidence: TAS. Frequency: Occasional (HP:0040283). (ORPHA:2658)
- Limitation of joint mobility (HP:0001376): A reduction in the freedom of movement of one or more joints. Evidence: TAS. Frequency: Occasional (HP:0040283). (ORPHA:2658)
- Hypoplastic fingernail (HP:0001804): Underdevelopment of a fingernail. Evidence: TAS. Frequency: Occasional (HP:0040283). (ORPHA:2658)
- Hyperconvex fingernails (HP:0001812): When viewed on end (with the finger tip pointing toward the examiner's eye) the curve of the fingernail forms a tighter curve of convexity. Evidence: TAS. Frequency: Occasional (HP:0040283). (ORPHA:2658)
- Scoliosis (HP:0002650): The presence of an abnormal lateral curvature of the spine. Evidence: TAS. Frequency: Occasional (HP:0040283). (ORPHA:2658)
- High, narrow palate (HP:0002705): The presence of a high and narrow palate. Evidence: TAS. Frequency: Occasional (HP:0040283). (ORPHA:2658)
- Kyphosis (HP:0002808): Exaggerated anterior convexity of the thoracic vertebral column. Evidence: TAS. Frequency: Occasional (HP:0040283). (ORPHA:2658)
- External genital hypoplasia (HP:0003241): Underdevelopment of part or all of the external reproductive organs. Evidence: TAS. Frequency: Occasional (HP:0040283). (ORPHA:2658)